- Non-Mendelian inheritance (HP:0001426): A mode of inheritance that depends on genetic determinants in more than one gene. Evidence: TAS. (OMIM:103780)
- Addictive alcohol use (HP:0030955): An addictive behavior is defined as drinking excessive amounts of alcohol over a prolonged period of time, having difficulty in reducing the amount of alcohol consumed, strongly desiring alcohol, and experiencing withdrawal symptoms when not drinking alcohol. Evidence: TAS. (OMIM:103780)
These phenotypes are associated with the disease alcohol dependence (OMIM:103780).